Phenotypes associated with the disease Autism spectrum disorder due to AUTS2 deficiency (ORPHA:352490):
- Delayed speech and language development (HP:0000750): A degree of language development that is significantly below the norm for a child of a specified age. Evidence: TAS. Frequency: Very frequent (HP:0040281). (ORPHA:352490)
- Intellectual disability (HP:0001249): The term intellectual disability or intellectual developmental disorder is used to describe significantly sub-average intellectual and adaptive functioning based on clinical assessment and as measured by individually administered, appropriately normed, standardized and validated tests of intellectual functioning and adaptive behavior, with onset during the developmental period from infancy through adolescence. Evidence: TAS. Frequency: Very frequent (HP:0040281). (ORPHA:352490)
- Abnormal facial shape (HP:0001999): An abnormal morphology (form) of the face or its components. Evidence: TAS. Frequency: Very frequent (HP:0040281). (ORPHA:352490)
- Narrow mouth (HP:0000160): Distance between the commissures of the mouth more than 2 SD below the mean. Alternatively, an apparently decreased width of the oral aperture (subjective). Evidence: TAS. Frequency: Frequent (HP:0040282). (ORPHA:352490)
- Microcephaly (HP:0000252): Head circumference below 2 standard deviations below the mean for age and gender. Evidence: TAS. Frequency: Frequent (HP:0040282). (ORPHA:352490)
- Epicanthus (HP:0000286): A fold of skin starting above the medial aspect of the upper eyelid and arching downward to cover, pass in front of and lateral to the medial canthus. Evidence: TAS. Frequency: Frequent (HP:0040282). (ORPHA:352490)
- Hypertelorism (HP:0000316): Interpupillary distance more than 2 SD above the mean (alternatively, the appearance of an increased interpupillary distance or widely spaced eyes). Evidence: TAS. Frequency: Frequent (HP:0040282). (ORPHA:352490)
- Short philtrum (HP:0000322): Distance between nasal base and midline upper lip vermilion border more than 2 SD below the mean. Alternatively, an apparently decreased distance between nasal base and midline upper lip vermilion border. Evidence: TAS. Frequency: Frequent (HP:0040282). (ORPHA:352490)
- Micrognathia (HP:0000347): Developmental hypoplasia of the mandible. Evidence: TAS. Frequency: Frequent (HP:0040282). (ORPHA:352490)
- Low-set ears (HP:0000369): Upper insertion of the ear to the scalp below an imaginary horizontal line drawn between the inner canthi of the eye and extending posteriorly to the ear. Evidence: TAS. Frequency: Frequent (HP:0040282). (ORPHA:352490)
- Wide nasal bridge (HP:0000431): Increased breadth of the nasal bridge (and with it, the nasal root). Evidence: TAS. Frequency: Frequent (HP:0040282). (ORPHA:352490)
- Strabismus (HP:0000486): A misalignment of the eyes so that the visual axes deviate from bifoveal fixation. The classification of strabismus may be based on a number of features including the relative position of the eyes, whether the deviation is latent or manifest, intermittent or constant, concomitant or otherwise and according to the age of onset and the relevance of any associated refractive error. Evidence: TAS. Frequency: Frequent (HP:0040282). (ORPHA:352490)
- Proptosis (HP:0000520): An eye that is protruding anterior to the plane of the face to a greater extent than is typical. Evidence: TAS. Frequency: Frequent (HP:0040282). (ORPHA:352490)
- Compulsive behaviors (HP:0000722): Behavior that consists of repetitive acts, characterized by the feeling that one "has to" perform them, while being aware that these acts are not in line with one's overall goal. Evidence: TAS. Frequency: Frequent (HP:0040282). (ORPHA:352490)
- Autistic behavior (HP:0000729): Persistent deficits in social interaction and communication and interaction as well as a markedly restricted repertoire of activity and interest as well as repetitive patterns of behavior. Evidence: TAS. Frequency: Frequent (HP:0040282). (ORPHA:352490)
- Motor stereotypy (HP:0000733): Use of the same abnormal action in response to certain triggers or at random. They may be used as a way to regulate one's internal state but must otherwise have no apparent functional purpose. Evidence: TAS. Frequency: Frequent (HP:0040282). (ORPHA:352490)
- Global developmental delay (HP:0001263): A delay in the achievement of motor or mental milestones in the domains of development of a child, including motor skills, speech and language, cognitive skills, and social and emotional skills. This term should only be used to describe children younger than five years of age. Evidence: TAS. Frequency: Frequent (HP:0040282). (ORPHA:352490)
- Generalized hypotonia (HP:0001290): Generalized muscular hypotonia (abnormally low muscle tone). Evidence: TAS. Frequency: Frequent (HP:0040282). (ORPHA:352490)
- Specific learning disability (HP:0001328): Impairment of certain skills such as reading or writing, coordination, self-control, or attention that interfere with the ability to learn. The impairment is not related to a global deficiency of intelligence. Evidence: TAS. Frequency: Frequent (HP:0040282). (ORPHA:352490)
- Bilateral ptosis (HP:0001488). Evidence: TAS. Frequency: Frequent (HP:0040282). (ORPHA:352490)
- Small for gestational age (HP:0001518): Smaller than normal size according to sex and gestational age related norms, defined as a weight below the 10th percentile for the gestational age. Evidence: TAS. Frequency: Frequent (HP:0040282). (ORPHA:352490)
- Highly arched eyebrow (HP:0002553): Increased height of the central portion of the eyebrow, forming a crescent, semicircular, or inverted U shape. Evidence: TAS. Frequency: Frequent (HP:0040282). (ORPHA:352490)
- Short stature (HP:0004322): A height below that which is expected according to age and gender norms. Although there is no universally accepted definition of short stature, many refer to "short stature" as height more than 2 standard deviations below the mean for age and gender (or below the 3rd percentile for age and gender dependent norms). Evidence: TAS. Frequency: Frequent (HP:0040282). (ORPHA:352490)
- Repetitive compulsive behavior (HP:0008762). Evidence: TAS. Frequency: Frequent (HP:0040282). (ORPHA:352490)
- Feeding difficulties in infancy (HP:0008872): Impaired feeding performance of an infant as manifested by difficulties such as weak and ineffective sucking, brief bursts of sucking, and falling asleep during sucking. There may be difficulties with chewing or maintaining attention. Evidence: TAS. Frequency: Frequent (HP:0040282). (ORPHA:352490)
- Short palpebral fissure (HP:0012745): Distance between the medial and lateral canthi is more than 2 SD below the mean for age (objective); or, apparently reduced length of the palpebral fissures. Evidence: TAS. Frequency: Frequent (HP:0040282). (ORPHA:352490)
- Auditory sensitivity (HP:0025112): Decreased tolerance to sound. Evidence: TAS. Frequency: Frequent (HP:0040282). (ORPHA:352490)
- Inguinal hernia (HP:0000023): Protrusion of the contents of the abdominal cavity through the inguinal canal. Evidence: TAS. Frequency: Occasional (HP:0040283). (ORPHA:352490)
- Cryptorchidism (HP:0000028): Testis in inguinal canal. That is, absence of one or both testes from the scrotum owing to failure of the testis or testes to descend through the inguinal canal to the scrotum. Evidence: TAS. Frequency: Occasional (HP:0040283). (ORPHA:352490)
- Retrognathia (HP:0000278): An abnormality in which the mandible is mislocalised posteriorly. Evidence: TAS. Frequency: Occasional (HP:0040283). (ORPHA:352490)
- Anteverted nares (HP:0000463): Anteriorly-facing nostrils viewed with the head in the Frankfurt horizontal and the eyes of the observer level with the eyes of the subject. This gives the appearance of an upturned nose (upturned nasal tip). Evidence: TAS. Frequency: Occasional (HP:0040283). (ORPHA:352490)
- Upslanted palpebral fissure (HP:0000582): The palpebral fissure inclination is more than two standard deviations above the mean for age (objective); or, the inclination of the palpebral fissure is greater than typical for age. Evidence: TAS. Frequency: Occasional (HP:0040283). (ORPHA:352490)
- Hyperactivity (HP:0000752): Hyperactivity is a condition characterized by constant and unusually high levels of activity, even in situations where it is deemed inappropriate. Evidence: TAS. Frequency: Occasional (HP:0040283). (ORPHA:352490)
- Eczematoid dermatitis (HP:0000964): Eczema is a form of dermatitis that is characterized by scaly, pruritic, erythematous lesions located on flexural surfaces. Evidence: TAS. Frequency: Occasional (HP:0040283). (ORPHA:352490)
- Seizure (HP:0001250): A seizure is an intermittent abnormality of nervous system physiology characterized by a transient occurrence of signs and/or symptoms due to abnormal excessive or synchronous neuronal activity in the brain. Evidence: TAS. Frequency: Occasional (HP:0040283). (ORPHA:352490)
- Spasticity (HP:0001257): A motor disorder characterized by a velocity-dependent increase in tonic stretch reflexes with increased muscle tone, exaggerated (hyperexcitable) tendon reflexes. Evidence: TAS. Frequency: Occasional (HP:0040283). (ORPHA:352490)
- Hypertonia (HP:0001276): A condition in which there is increased muscle tone so that arms or legs, for example, are stiff and difficult to move. Evidence: TAS. Frequency: Occasional (HP:0040283). (ORPHA:352490)
- Hyperreflexia (HP:0001347): Hyperreflexia is the presence of hyperactive stretch reflexes of the muscles. Evidence: TAS. Frequency: Occasional (HP:0040283). (ORPHA:352490)
- Umbilical hernia (HP:0001537): Protrusion of abdominal contents through a defect in the abdominal wall musculature around the umbilicus. Skin and subcutaneous tissue overlie the defect. Evidence: TAS. Frequency: Occasional (HP:0040283). (ORPHA:352490)
- Abnormal heart morphology (HP:0001627): Any structural anomaly of the heart. Evidence: TAS. Frequency: Occasional (HP:0040283). (ORPHA:352490)
- Atrial septal defect (HP:0001631): Atrial septal defect (ASD) is a congenital abnormality of the interatrial septum that enables blood flow between the left and right atria via the interatrial septum. Evidence: TAS. Frequency: Occasional (HP:0040283). (ORPHA:352490)
- Abnormal foot morphology (HP:0001760): An abnormality of the skeleton of foot. Evidence: TAS. Frequency: Occasional (HP:0040283). (ORPHA:352490)
- Scoliosis (HP:0002650): The presence of an abnormal lateral curvature of the spine. Evidence: TAS. Frequency: Occasional (HP:0040283). (ORPHA:352490)
- Congenital contracture (HP:0002803): One or more flexion contractures (a bent joint that cannot be straightened actively or passively) that are present at birth. Evidence: TAS. Frequency: Occasional (HP:0040283). (ORPHA:352490)
- Arthrogryposis multiplex congenita (HP:0002804): Multiple congenital contractures in different body areas. Evidence: TAS. Frequency: Occasional (HP:0040283). (ORPHA:352490)
- Kyphosis (HP:0002808): Exaggerated anterior convexity of the thoracic vertebral column. Evidence: TAS. Frequency: Occasional (HP:0040283). (ORPHA:352490)
- Narrow palm (HP:0004283): For children from birth to 4 years of age, the palm width is more than 2 SD below the mean; for children from 4 to 16 years of age the palm width is below the 5th centile; or, the width of the palm appears disproportionately narrow for its length. Evidence: TAS. Frequency: Occasional (HP:0040283). (ORPHA:352490)
- Prominent nasal tip (HP:0005274). Evidence: TAS. Frequency: Occasional (HP:0040283). (ORPHA:352490)
- Decreased palmar creases (HP:0006184): Poorly defined or shallow palmar creases. Evidence: TAS. Frequency: Occasional (HP:0040283). (ORPHA:352490)
- Attention deficit hyperactivity disorder (HP:0007018): Attention deficit hyperactivity disorder (ADHD) manifests at age 2-3 years or by first grade at the latest. The main symptoms are distractibility, impulsivity, hyperactivity, and often trouble organizing tasks and projects, difficulty going to sleep, and social problems from being aggressive, loud, or impatient. Evidence: TAS. Frequency: Occasional (HP:0040283). (ORPHA:352490)
- Joint contracture of the 5th finger (HP:0009183): Chronic loss of joint motion in the 5th finger due to structural changes in non-bony tissue. The term camptodactyly of the 5th finger is used if the distal and/or proximal interphalangeal joints are affected. Evidence: TAS. Frequency: Occasional (HP:0040283). (ORPHA:352490)
- Joint contracture of the hand (HP:0009473): Contractures of one ore more joints of the hands meaning chronic loss of joint motion due to structural changes in non-bony tissue. Evidence: TAS. Frequency: Occasional (HP:0040283). (ORPHA:352490)
- Abnormal brain morphology (HP:0012443): A structural abnormality of the brain, which has as its parts the forebrain, midbrain, and hindbrain. Evidence: TAS. Frequency: Occasional (HP:0040283). (ORPHA:352490)
- Cerebral palsy (HP:0100021): Cerebral palsy describes a group of permanent disorders of the development of movement and posture, causing activity limitation, that are attributed to nonprogressive disturbances that occurred in the developing fetal or infant brain. The motor disorders of cerebral palsy are often accompanied by disturbances of sensation, perception, cognition, communication, and behavior, by epilepsy, and by secondary musculoskeletal problems. Evidence: TAS. Frequency: Occasional (HP:0040283). (ORPHA:352490)
- Periauricular skin pits (HP:0100277): Benign congenital lesions of the periauricular soft tissue consisting of a blind-ending narrow tube or pit. Evidence: TAS. Frequency: Occasional (HP:0040283). (ORPHA:352490)